- Talipes equinovarus (HP:0001762): Talipes equinovarus (also called clubfoot) typically has four main components: inversion and adduction of the forefoot; inversion of the heel and hindfoot; equinus (limitation of extension) of the ankle and subtalar joint; and internal rotation of the leg. Evidence: TAS. (OMIM:610244)
- Babinski sign (HP:0003487): Upturning of the big toe (and sometimes fanning of the other toes) in response to stimulation of the sole of the foot. If the Babinski sign is present it can indicate damage to the corticospinal tract. Evidence: TAS. (OMIM:610244)
- Lower limb muscle weakness (HP:0007340): Weakness of the muscles of the legs. Evidence: TAS. (OMIM:610244)
- Spastic gait (HP:0002064): Spasticity is manifested by increased stretch reflex which is intensified with movement velocity. This results in excessive and inappropriate muscle activation which can contribute to muscle hypertonia. Spastic gait is characterized by manifestations such as muscle hypertonia, stiff knee, and circumduction of the leg. Evidence: TAS. Onset: Adult onset (HP:0003581). (OMIM:610244)
- Lower limb spasticity (HP:0002061): Spasticity (velocity-dependent increase in tonic stretch reflexes with increased muscle tone and hyperexcitable tendon reflexes) in the muscles of the lower limbs, hips, and pelvis. Evidence: TAS. (OMIM:610244)
- Spastic paraplegia (HP:0001258): Complete loss of the ability to move the lower limbs accompanied by spasticity of the lower limbs. Evidence: IEA. (OMIM:610244)
- Autosomal dominant inheritance (HP:0000006): A mode of inheritance that is observed for traits related to a gene encoded on one of the autosomes (i.e., the human chromosomes 1-22) in which a trait manifests in heterozygotes. In the context of medical genetics, an autosomal dominant disorder is caused when a single copy of the mutant allele is present. Males and females are affected equally, and can both transmit the disorder with a risk of 50% for each child of inheriting the mutant allele. Evidence: TAS. (OMIM:610244)
- Ankle clonus (HP:0011448): Clonus is an involuntary tendon reflex that causes repeated flexion and extension of the foot. Ankle clonus is tested by rapidly flexing the foot upward. Evidence: TAS. (OMIM:610244)
- Hyperreflexia (HP:0001347): Hyperreflexia is the presence of hyperactive stretch reflexes of the muscles. Evidence: TAS. (OMIM:610244)
These phenotypes are associated with the disease hereditary spastic paraplegia 33 (OMIM:610244).